Phenotypes associated with the disease lip, hamartomatous (OMIM:151640):
- Abnormality of the mouth (HP:0000153): An abnormality of the mouth. Evidence: IEA. (OMIM:151640)
- Hamartoma (HP:0010566): A disordered proliferation of mature tissues that is native to the site of origin, e.g., exostoses, nevi and soft tissue hamartomas. Although most hamartomas are benign, some histologic subtypes, e.g., neuromuscular hamartoma, may proliferate aggressively such as mesenchymal cystic hamartoma, Sclerosing epithelial hamartoma, Sclerosing metanephric hamartoma. Evidence: IEA. (OMIM:151640)
- Autosomal dominant inheritance (HP:0000006): A mode of inheritance that is observed for traits related to a gene encoded on one of the autosomes (i.e., the human chromosomes 1-22) in which a trait manifests in heterozygotes. In the context of medical genetics, an autosomal dominant disorder is caused when a single copy of the mutant allele is present. Males and females are affected equally, and can both transmit the disorder with a risk of 50% for each child of inheriting the mutant allele. Evidence: IEA. (OMIM:151640)